Phenotypes associated with the disease Non-specific autoimmune cerebellar ataxia with characteristic antibodies (ORPHA:624259):
- Anti-Glutamate Receptor delta2 antibody positivity (HP:6000876): The presence of autoantibodies in the serum that react against glutamate receptor delta2. Evidence: TAS. Frequency: Frequent (HP:0040282). (ORPHA:624259)
- Anti-regulator of G protein signaling 8 antibody positivity (HP:6000879): The presence of autoantibodies in the serum that react against regulator of G-protein signaling 8 (RGS8). Evidence: TAS. Frequency: Frequent (HP:0040282). (ORPHA:624259)
- Anti-neurochondrin antibody positivity (HP:6000880): The presence of autoantibodies in the serum that react against neurochondrin . Evidence: TAS. Frequency: Frequent (HP:0040282). (ORPHA:624259)